Phenotypes associated with the disease Distal 17p13.1 microdeletion syndrome (ORPHA:319171):
- Microcephaly (HP:0000252): Head circumference below 2 standard deviations below the mean for age and gender. Evidence: TAS. Frequency: Frequent (HP:0040282). (ORPHA:319171)
- Retrognathia (HP:0000278): An abnormality in which the mandible is mislocalised posteriorly. Evidence: TAS. Frequency: Frequent (HP:0040282). (ORPHA:319171)
- Triangular face (HP:0000325): Facial contour, as viewed from the front, triangular in shape, with breadth at the temples and tapering to a narrow chin. Evidence: TAS. Frequency: Frequent (HP:0040282). (ORPHA:319171)
- Prominent nasal bridge (HP:0000426): Anterior positioning of the nasal root in comparison to the usual positioning for age. Evidence: TAS. Frequency: Frequent (HP:0040282). (ORPHA:319171)
- Motor delay (HP:0001270): A type of Developmental delay characterized by a delay in acquiring motor skills. Evidence: TAS. Frequency: Frequent (HP:0040282). (ORPHA:319171)
- Abnormal facial shape (HP:0001999): An abnormal morphology (form) of the face or its components. Evidence: TAS. Frequency: Frequent (HP:0040282). (ORPHA:319171)
- Postural instability (HP:0002172): A tendency to fall or the inability to keep oneself from falling; imbalance. The retropulsion test is widely regarded as the gold standard to evaluate postural instability, Use of the retropulsion test includes a rapid balance perturbation in the backward direction, and the number of balance correcting steps (or total absence thereof) is used to rate the degree of postural instability. Healthy subjects correct such perturbations with either one or two large steps, or without taking any steps, hinging rapidly at the hips while swinging the arms forward as a counterweight. In patients with balance impairment, balance correcting steps are often too small, forcing patients to take more than two steps. Taking three or more steps is generally considered to be abnormal, and taking more than five steps is regarded as being clearly abnormal. Markedly affected patients continue to step backward without ever regaining their balance and must be caught by the examiner (this would be called true retropulsion). Even more severely affected patients fail to correct entirely, and fall backward like a pushed toy soldier, without taking any corrective steps. Evidence: TAS. Frequency: Frequent (HP:0040282). (ORPHA:319171)
- Floppy infant (HP:0008947): Floppiness/hypotonia is defined as reduced resistance to passive movement of joints. Physical examination of floppy/hypotonic infants shows head lag, lack of shoulder and elbow muscle contraction on traction response, inability to tighten the shoulder girdle muscles (or slipping through) when held under the axillae, scarf sign (when the arm is pulled to the opposite side, the arm wraps around the neck with the elbow crossing midline), hyperdorsiflexion of the feet, easy apposition of the thumb against the forearm, feet touching the cheek with ease and without discomfort, frog leg position, and inverted U sign on ventral suspension (head, arms, and legs hanging down without elbow or knee flexion and the trunk rounded in a dome shape). Evidence: TAS. Frequency: Frequent (HP:0040282). (ORPHA:319171)
- Increased overbite (HP:0011094): Maxillary teeth cover the mandibular teeth when biting to an increased degree. The feature is defined as a vertical overlap of the maxillary incisors over the mandibular incisors that exceeds 2 mm. Evidence: TAS. Frequency: Frequent (HP:0040282). (ORPHA:319171)
- Moderate global developmental delay (HP:0011343): A moderate delay in the achievement of motor or mental milestones in the domains of development of a child. Evidence: TAS. Frequency: Frequent (HP:0040282). (ORPHA:319171)
- High palate (HP:0000218): Height of the palate more than 2 SD above the mean (objective) or palatal height at the level of the first permanent molar more than twice the height of the teeth (subjective). Evidence: TAS. Frequency: Occasional (HP:0040283). (ORPHA:319171)
- Narrow forehead (HP:0000341): Width of the forehead or distance between the frontotemporales is more than two standard deviations below the mean (objective); or apparently narrow intertemporal region (subjective). Evidence: TAS. Frequency: Occasional (HP:0040283). (ORPHA:319171)
- Protruding ear (HP:0000411): Angle formed by the plane of the ear and the mastoid bone greater than the 97th centile for age (objective); or, outer edge of the helix more than 2 cm from the mastoid at the point of maximum distance (objective). Evidence: TAS. Frequency: Occasional (HP:0040283). (ORPHA:319171)
- Deeply set eye (HP:0000490): An eye that is more deeply recessed into the plane of the face than is typical. Evidence: TAS. Frequency: Occasional (HP:0040283). (ORPHA:319171)
- Arachnodactyly (HP:0001166): Abnormally long and slender fingers (spider fingers). Evidence: TAS. Frequency: Occasional (HP:0040283). (ORPHA:319171)
- Generalized joint hypermobility (HP:0002761): Joint hypermobility (ability of a joint to move beyond its normal range of motion) affecting many or all joints of the body. In individuals with Joint hypermobility at multiple sites (usually five or more), the term generalized joint hypermobility is preferred. Evidence: TAS. Frequency: Occasional (HP:0040283). (ORPHA:319171)
- Limited elbow movement (HP:0002996). Evidence: TAS. Frequency: Occasional (HP:0040283). (ORPHA:319171)
- Flat occiput (HP:0005469): Reduced convexity of the occiput (posterior part of skull). Evidence: TAS. Frequency: Occasional (HP:0040283). (ORPHA:319171)
- Abnormal hand morphology (HP:0005922): Any structural anomaly of the hand. Evidence: TAS. Frequency: Occasional (HP:0040283). (ORPHA:319171)
- Unilateral polymicrogyria (HP:0006927): Excessive number of small gyri (convolutions) on the surface of one side of the brain. Evidence: TAS. Frequency: Occasional (HP:0040283). (ORPHA:319171)
- Limitation of knee mobility (HP:0010501): An abnormal limitation of knee joint mobility. Evidence: TAS. Frequency: Occasional (HP:0040283). (ORPHA:319171)
- Hypoplasia of the zygomatic bone (HP:0010669): Underdevelopment of the zygomatic bone. That is, a reduction in size of the zygomatic bone, including the zygomatic process of the temporal bone of the skull, which forms part of the zygomatic arch. Evidence: TAS. Frequency: Occasional (HP:0040283). (ORPHA:319171)
- EEG with spike-wave complexes (HP:0010850): Complexes of spikes (<70 ms) and sharp waves (70-200 ms), which are sharp transient waves that have a strong association with epilepsy, in cerebral electrical activity recorded along the scalp by electroencephalography (EEG). Evidence: TAS. Frequency: Occasional (HP:0040283). (ORPHA:319171)